- Male infertility (HP:0003251). Evidence: PCS. Frequency: 3/3. (PMID:35587281;PMID:29790874)
- Young adult onset (HP:0011462): Onset of disease at the age of between 16 and 40 years. Evidence: PCS. Frequency: 2/2. (PMID:29790874)
- Autosomal recessive inheritance (HP:0000007): A mode of inheritance that is observed for traits related to a gene encoded on one of the autosomes (i.e., the human chromosomes 1-22) in which a trait manifests in individuals with two pathogenic alleles, either homozygotes (two copies of the same mutant allele) or compound heterozygotes (whereby each copy of a gene has a distinct mutant allele). Evidence: PCS. (PMID:29790874)
- Non-obstructive azoospermia (HP:0011961): Absence of any measurable level of sperm in his semen, resulting from a defect in the production of spermatozoa in the testes. This can be differentiated from obstructive azoospermia on the basis of testicular biopsy. Evidence: PCS. Frequency: 3/3. (PMID:35587281;PMID:29790874)
- Spermatocyte maturation arrest (HP:0031039): A type of spermatogenesis maturation arrest in which the block of developmental occurs in the spermatocyte stage. Testicular histology shows seminiferous tubules with Sertoli cells, spermatogonial cells and spermatocytes but no further differentiated cells like round spermatids. Evidence: PCS. Frequency: 2/2. (PMID:29790874)
These phenotypes are associated with the disease spermatogenic failure 88 (OMIM:620547).